- Hypertension (HP:0000822): The presence of chronic increased pressure in the systemic arterial system. Evidence: TAS. Frequency: Occasional (HP:0040283). (ORPHA:1879)
- Abnormality of the skin (HP:0000951): An abnormality of the skin. Evidence: TAS. Frequency: Occasional (HP:0040283). (ORPHA:1879)
- Multiple lipomas (HP:0001012): The presence of multiple lipomas (a type of benign tissue made of fatty tissue). Evidence: TAS. Frequency: Occasional (HP:0040283). (ORPHA:1879)
- Subcutaneous nodule (HP:0001482): Slightly elevated lesions on or in the skin with a diameter of over 5 mm. Evidence: TAS. Frequency: Occasional (HP:0040283). (ORPHA:1879)
- Abnormal cortical bone morphology (HP:0003103): An abnormality of compact bone (also known as cortical bone), which forms the dense surface of bones. Evidence: TAS. Frequency: Very frequent (HP:0040281). (ORPHA:1879)
- Complete duplication of the distal phalanges of the hand (HP:0010001): A complete duplication affecting one or more of the distal phalanges of the hand. Evidence: TAS. Frequency: Very frequent (HP:0040281). (ORPHA:1879)
- Osteopoikilosis (HP:0010739): Osteopoikilosis is a benign, asymptomatic sclerotic dysplasia of the bones. It affects both male and female and may be seen at any age. Radiographically sclerotic circular or ovoid lesions are usually symmetrically distributed in a periarticular location. Lesions can increase or decrease in size and number in serial radiographs or even disappear and do not have increased bone radiotracer uptake. Evidence: TAS. Frequency: Very frequent (HP:0040281). (ORPHA:1879)
These phenotypes are associated with the disease Melorheostosis with osteopoikilosis (ORPHA:1879).